Phenotypes associated with the disease midface hypoplasia, obesity, developmental delay, and neonatal hypotonia (OMIM:608624):
- Epicanthus (HP:0000286): A fold of skin starting above the medial aspect of the upper eyelid and arching downward to cover, pass in front of and lateral to the medial canthus. Evidence: PCS. Frequency: 2/2. (PMID:12514359)
- Congenital onset (HP:0003577): A phenotypic abnormality that is present at birth. Evidence: PCS. Frequency: 2/2. (PMID:12514359)
- Brachydactyly (HP:0001156): Digits that appear disproportionately short compared to the hand/foot. The word brachydactyly is used here to describe a series distinct patterns of shortened digits (brachydactyly types A-E). This is the sense used here. Evidence: PCS. Frequency: 2/2. (PMID:12514359)
- Anteverted nares (HP:0000463): Anteriorly-facing nostrils viewed with the head in the Frankfurt horizontal and the eyes of the observer level with the eyes of the subject. This gives the appearance of an upturned nose (upturned nasal tip). Evidence: PCS. Frequency: 2/2. (PMID:12514359)
- Narrow mouth (HP:0000160): Distance between the commissures of the mouth more than 2 SD below the mean. Alternatively, an apparently decreased width of the oral aperture (subjective). Evidence: PCS. Frequency: 2/2. (PMID:12514359)
- Generalized hypotonia (HP:0001290): Generalized muscular hypotonia (abnormally low muscle tone). Evidence: PCS. Frequency: 1/2. (PMID:12514359)
- Gray matter heterotopia (HP:0002282): Heterotopia or neuronal heterotopia are macroscopic clusters of misplaced neurons (gray matter), most often situated along the ventricular walls or within the subcortical white matter. Evidence: PCS. Frequency: 1/1. (PMID:12514359)
- Prominent forehead (HP:0011220): Forward prominence of the entire forehead, due to protrusion of the frontal bone. Evidence: PCS. Frequency: 2/2. (PMID:12514359)
- Fetal distress (HP:0025116): An intrauterine state characterized by suboptimal values in the fetal heart rate, oxygenation of fetal blood, or other parameters indicative of compromise of the fetus. Signs of fetal distress include repetitive variable decelerations, fetal tachycardia or bradycardia, late decelerations, or low biophysical profile. Evidence: PCS. Frequency: 1/2. (PMID:12514359)
- Thick lower lip vermilion (HP:0000179): Increased thickness of the lower lip, leading to a prominent appearance of the lower lip. The height of the vermilion of the lower lip in the midline is more than 2 SD above the mean. Alternatively, an apparently increased height of the vermilion of the lower lip in the frontal view (subjective). Evidence: PCS. Frequency: 2/2. (PMID:12514359)
- Mixed hearing impairment (HP:0000410): A type of hearing loss resulting from a combination of conductive hearing impairment and sensorineural hearing impairment. Evidence: PCS. Frequency: 1/2. (PMID:12514359)
- Thick upper lip vermilion (HP:0000215): Height of the vermilion of the upper lip in the midline more than 2 SD above the mean. Alternatively, an apparently increased height of the vermilion of the upper lip in the frontal view (subjective). Evidence: PCS. Frequency: 2/2. (PMID:12514359)
- Overfolded helix (HP:0000396): A condition in which the helix is folded over to a greater degree than normal. That is, excessive curling of the helix edge, whereby the free edge is parallel to the plane of the ear. Evidence: PCS. Frequency: 2/2. (PMID:12514359)
- Underdeveloped nasal alae (HP:0000430): Thinned, deficient, or excessively arched ala nasi. Evidence: PCS. Frequency: 2/2. (PMID:12514359)
- Delayed skeletal maturation (HP:0002750): A decreased rate of skeletal maturation. Delayed skeletal maturation can be diagnosed on the basis of an estimation of the bone age from radiographs of specific bones in the human body. Evidence: PCS. Frequency: 1/2. (PMID:12514359)
- Full cheeks (HP:0000293): Increased prominence or roundness of soft tissues between zygomata and mandible. Evidence: PCS. Frequency: 2/2. (PMID:12514359)
- Thickened helices (HP:0000391): Increased thickness of the helix of the ear. Evidence: PCS. Frequency: 2/2. (PMID:12514359)
- Global developmental delay (HP:0001263): A delay in the achievement of motor or mental milestones in the domains of development of a child, including motor skills, speech and language, cognitive skills, and social and emotional skills. This term should only be used to describe children younger than five years of age. Evidence: PCS. Frequency: 2/2. (PMID:12514359)
- Midface retrusion (HP:0011800): Posterior positions and/or vertical shortening of the infraorbital and perialar regions, or increased concavity of the face and/or reduced nasolabial angle. Evidence: PCS. Frequency: 2/2. (PMID:12514359)
- Depressed nasal bridge (HP:0005280): Posterior positioning of the nasal root in relation to the overall facial profile for age. Evidence: PCS. Frequency: 2/2. (PMID:12514359)
- Ptosis (HP:0000508): The upper eyelid margin is positioned 3 mm or more lower than usual and covers the superior portion of the iris (objective); or, the upper lid margin obscures at least part of the pupil (subjective). Evidence: PCS. Frequency: 2/2. (PMID:12514359)
- Neonatal hypoglycemia (HP:0001998). Evidence: PCS. Frequency: 2/2. (PMID:12514359)
- Autosomal recessive inheritance (HP:0000007): A mode of inheritance that is observed for traits related to a gene encoded on one of the autosomes (i.e., the human chromosomes 1-22) in which a trait manifests in individuals with two pathogenic alleles, either homozygotes (two copies of the same mutant allele) or compound heterozygotes (whereby each copy of a gene has a distinct mutant allele). Evidence: IEA. (OMIM:608624)
- Neonatal hypotonia (HP:0001319): Muscular hypotonia (abnormally low muscle tone) manifesting in the neonatal period. Evidence: PCS. Frequency: 2/2. (PMID:12514359)
- Long eyelashes (HP:0000527): Mid upper eyelash length >10 mm or increased length of the eyelashes (subjective). Evidence: PCS. Frequency: 2/2. (PMID:12514359)
- Frontal bossing (HP:0002007): Bilateral bulging of the lateral frontal bone prominences with relative sparing of the midline. Evidence: PCS. Frequency: 2/2. (PMID:12514359)
- Obesity (HP:0001513): Accumulation of substantial excess body fat. Evidence: PCS. Frequency: 1/2. (PMID:12514359)
- Low-set ears (HP:0000369): Upper insertion of the ear to the scalp below an imaginary horizontal line drawn between the inner canthi of the eye and extending posteriorly to the ear. Evidence: PCS. Frequency: 2/2. (PMID:12514359)
- Broad lateral eyebrow (HP:0007933): Regional increase in the width (height) of the lateral eyebrow. Evidence: PCS. Frequency: 2/2. (PMID:12514359)